Phenotypes associated with the disease Vacuolar myopathy with sarcoplasmic reticulum protein aggregates (ORPHA:88635):
- Myopathy (HP:0003198): A disorder of muscle unrelated to impairment of innervation or neuromuscular junction. Evidence: TAS. Frequency: Very frequent (HP:0040281). (ORPHA:88635)
- Elevated circulating creatine kinase activity (HP:0003236): The activity of creatine kinase in the blood circulation is above the upper limit of normal. Evidence: TAS. Frequency: Very frequent (HP:0040281). (ORPHA:88635)